Phenotypes associated with the disease cardiofaciocutaneous syndrome 3 (OMIM:615279):
- Wide mouth (HP:0000154): Distance between the oral commissures more than 2 SD above the mean. Alternatively, an apparently increased width of the oral aperture (subjective). Evidence: PCS. (PMID:18042262)
- Curly hair (HP:0002212). Evidence: PCS. Frequency: 3/3. (PMID:16439621)
- Scoliosis (HP:0002650): The presence of an abnormal lateral curvature of the spine. Evidence: PCS. Frequency: 2/3. (PMID:16439621)
- Short stature (HP:0004322): A height below that which is expected according to age and gender norms. Although there is no universally accepted definition of short stature, many refer to "short stature" as height more than 2 standard deviations below the mean for age and gender (or below the 3rd percentile for age and gender dependent norms). Evidence: PCS. (PMID:18042262)
- Heat intolerance (HP:0002046): The inability to maintain a comfortable body temperature in warm or hot weather. Evidence: PCS. Frequency: 3/3. (PMID:16439621)
- Seizure (HP:0001250): A seizure is an intermittent abnormality of nervous system physiology characterized by a transient occurrence of signs and/or symptoms due to abnormal excessive or synchronous neuronal activity in the brain. Evidence: PCS. Frequency: 1/3. (PMID:16439621)
- Hypotonia (HP:0001252): Hypotonia is an abnormally low muscle tone (the amount of tension or resistance to movement in a muscle). Even when relaxed, muscles have a continuous and passive partial contraction which provides some resistance to passive stretching. Hypotonia thus manifests as diminished resistance to passive stretching. Hypotonia is not the same as muscle weakness, although the two conditions can co-exist. Evidence: PCS. Frequency: 3/3. (PMID:16439621)
- Global developmental delay (HP:0001263): A delay in the achievement of motor or mental milestones in the domains of development of a child, including motor skills, speech and language, cognitive skills, and social and emotional skills. This term should only be used to describe children younger than five years of age. Evidence: PCS. (PMID:16439621)
- Short neck (HP:0000470): Diminished length of the neck. Evidence: PCS. (PMID:18042262)
- Ventricular septal defect (HP:0001629): A hole between the two bottom chambers (ventricles) of the heart. The defect is centered around the most superior aspect of the ventricular septum. Evidence: PCS. (PMID:18042262)
- Nystagmus (HP:0000639): Rhythmic, involuntary oscillations of one or both eyes related to abnormality in fixation, conjugate gaze, or vestibular mechanisms. Evidence: PCS. (PMID:16439621)
- Keratosis pilaris (HP:0032152): An anomaly of the hair follicles of the skin that typically presents as small, rough, brown folliculocentric papules distributed over characteristic areas of the skin, particularly the outer-upper arms and thighs. Evidence: PCS. (PMID:18042262)
- Failure to thrive (HP:0001508): Failure to thrive (FTT) refers to a child whose physical growth is substantially below the norm. Evidence: PCS. (PMID:16439621)
- Hypertrophic cardiomyopathy (HP:0001639): Hypertrophic cardiomyopathy (HCM) is defined by the presence of increased ventricular wall thickness or mass in the absence of loading conditions (hypertension, valve disease) sufficient to cause the observed abnormality. Evidence: PCS. (PMID:18042262)
- Pectus excavatum (HP:0000767): A defect of the chest wall characterized by a depression of the sternum, giving the chest ("pectus") a caved-in ("excavatum") appearance. Evidence: PCS. Frequency: 3/3. (PMID:16439621)
- Hyperhidrosis (HP:0000975): Abnormal excessive perspiration (sweating) despite the lack of appropriate stimuli like hot and humid weather. Evidence: PCS. Frequency: 3/3. (PMID:16439621)
- Webbed neck (HP:0000465): Pterygium colli is a congenital skin fold that runs along the sides of the neck down to the shoulders. It involves an ectopic fibrotic facial band superficial to the trapezius muscle. Excess hair-bearing skin is also present and extends down the cervical region well beyond the normal hairline. Evidence: PCS. (PMID:18042262)
- Pulmonic stenosis (HP:0001642): A narrowing of the right ventricular outflow tract that can occur at the pulmonary valve (valvular stenosis), below the pulmonary valve (infundibular stenosis), or above the pulmonary valve (supravalvar stenosis). Evidence: PCS. (PMID:18042262)
- Atrial septal defect (HP:0001631): Atrial septal defect (ASD) is a congenital abnormality of the interatrial septum that enables blood flow between the left and right atria via the interatrial septum. Evidence: PCS. (PMID:18042262)
- Reduced bone mineral density (HP:0004349): A reduction of bone mineral density, that is, of the amount of matter per cubic centimeter of bones. Evidence: PCS. Frequency: 1/3. (PMID:16439621)
- Intellectual disability (HP:0001249): The term intellectual disability or intellectual developmental disorder is used to describe significantly sub-average intellectual and adaptive functioning based on clinical assessment and as measured by individually administered, appropriately normed, standardized and validated tests of intellectual functioning and adaptive behavior, with onset during the developmental period from infancy through adolescence. Evidence: PCS. (PMID:18042262)
- Autosomal dominant inheritance (HP:0000006): A mode of inheritance that is observed for traits related to a gene encoded on one of the autosomes (i.e., the human chromosomes 1-22) in which a trait manifests in heterozygotes. In the context of medical genetics, an autosomal dominant disorder is caused when a single copy of the mutant allele is present. Males and females are affected equally, and can both transmit the disorder with a risk of 50% for each child of inheriting the mutant allele. Evidence: PCS. (PMID:18042262)
- Hyperkeratosis (HP:0000962): Hyperkeratosis is a histopathological term defining a thickened stratum corneum and may be present in many different skin conditions, with many possible overlaps. Hyperkeratosis refers to the increased thickness of the stratum corneum, the outer layer of the skin. Hyperkeratosis is subclassified as orthokeratotic or parakeratotic. Orthokeratotic hyperkeratosis refers to the thickening of the keratin layer with preserved keratinocyte maturation, while parakeratotic hyperkeratosis shows retained nuclei as a sign of delayed maturation of keratinocytes. Evidence: PCS. Frequency: 3/3. (PMID:16439621)